Phenotypes associated with the disease cranial nerves, recurrent paresis of (OMIM:218200):
- Diabetes mellitus (HP:0000819): A group of abnormalities characterized by hyperglycemia and glucose intolerance. Evidence: IEA. (OMIM:218200)
- Facial palsy (HP:0010628): Facial nerve palsy is a dysfunction of cranial nerve VII (the facial nerve) that results in inability to control facial muscles on the affected side with weakness of the muscles of facial expression and eye closure. This can either be present in unilateral or bilateral form. Evidence: IEA. (OMIM:218200)
- Recurrent external ophthalmoplegia (HP:0007250): Alternating and recurrent weakness of the external ocular muscles. Evidence: IEA. (OMIM:218200)
- Peripheral neuropathy (HP:0009830): Peripheral neuropathy is a general term for any disorder of the peripheral nervous system. The main clinical features used to classify peripheral neuropathy are distribution, type (mainly demyelinating versus mainly axonal), duration, and course. Evidence: IEA. (OMIM:218200)
- Autosomal recessive inheritance (HP:0000007): A mode of inheritance that is observed for traits related to a gene encoded on one of the autosomes (i.e., the human chromosomes 1-22) in which a trait manifests in individuals with two pathogenic alleles, either homozygotes (two copies of the same mutant allele) or compound heterozygotes (whereby each copy of a gene has a distinct mutant allele). Evidence: TAS. (OMIM:218200)